- Inguinal hernia (HP:0000023): Protrusion of the contents of the abdominal cavity through the inguinal canal. Evidence: TAS. Frequency: Very frequent (HP:0040281). (ORPHA:579)
- Thick lower lip vermilion (HP:0000179): Increased thickness of the lower lip, leading to a prominent appearance of the lower lip. The height of the vermilion of the lower lip in the midline is more than 2 SD above the mean. Alternatively, an apparently increased height of the vermilion of the lower lip in the frontal view (subjective). Evidence: TAS. Frequency: Frequent (HP:0040282). (ORPHA:579)
- Gingival overgrowth (HP:0000212): Hyperplasia of the gingiva (that is, a thickening of the soft tissue overlying the alveolar ridge. The degree of thickening ranges from involvement of the interdental papillae alone to gingival overgrowth covering the entire tooth crown. Evidence: TAS. Frequency: Frequent (HP:0040282). (ORPHA:579)
- Everted lower lip vermilion (HP:0000232): An abnormal configuration of the lower lip such that it is turned outward i.e., everted, with the Inner aspect of the lower lip vermilion (normally opposing the teeth) being visible in a frontal view. Evidence: TAS. Frequency: Frequent (HP:0040282). (ORPHA:579)
- Hydrocephalus (HP:0000238): Hydrocephalus is an active distension of the ventricular system of the brain resulting from inadequate passage of CSF from its point of production within the cerebral ventricles to its point of absorption into the systemic circulation. Evidence: TAS. Frequency: Occasional (HP:0040283). (ORPHA:579)
- Sinusitis (HP:0000246): Inflammation of the paranasal sinuses owing to a viral, bacterial, or fungal infection, allergy, or an autoimmune reaction. Evidence: TAS. Frequency: Very frequent (HP:0040281). (ORPHA:579)
- Macrocephaly (HP:0000256): Occipitofrontal (head) circumference greater than 97th centile compared to appropriate, age matched, sex-matched normal standards. Alternatively, a apparently increased size of the cranium. Evidence: TAS. Frequency: Frequent (HP:0040282). (ORPHA:579)
- Dolichocephaly (HP:0000268): An abnormality of skull shape characterized by a increased anterior-posterior diameter, i.e., an increased antero-posterior dimension of the skull. Cephalic index less than 76%. Alternatively, an apparently increased antero-posterior length of the head compared to width. Often due to premature closure of the sagittal suture. Evidence: TAS. Frequency: Frequent (HP:0040282). (ORPHA:579)
- Abnormality of the face (HP:0000271): An abnormality of the face. Evidence: TAS. Frequency: Frequent (HP:0040282). (ORPHA:579)
- Coarse facial features (HP:0000280): Absence of fine and sharp appearance of brows, nose, lips, mouth, and chin, usually because of rounded and heavy features or thickened skin with or without thickening of subcutaneous and bony tissues. Evidence: TAS. Frequency: Very frequent (HP:0040281). (ORPHA:579)
- Full cheeks (HP:0000293): Increased prominence or roundness of soft tissues between zygomata and mandible. Evidence: TAS. Frequency: Frequent (HP:0040282). (ORPHA:579)
- Low anterior hairline (HP:0000294): Distance between the hairline (trichion) and the glabella (the most prominent point on the frontal bone above the root of the nose), in the midline, more than two SD below the mean. Alternatively, an apparently decreased distance between the hairline and the glabella. Evidence: TAS. Frequency: Frequent (HP:0040282). (ORPHA:579)
- Hearing impairment (HP:0000365): A decreased magnitude of the sensory perception of sound. Evidence: TAS. Frequency: Frequent (HP:0040282). (ORPHA:579)
- Chronic otitis media (HP:0000389): Chronic otitis media refers to fluid, swelling, or infection of the middle ear that does not heal and may cause permanent damage to the ear. Evidence: TAS. Frequency: Very frequent (HP:0040281). (ORPHA:579)
- Sensorineural hearing impairment (HP:0000407): A type of hearing impairment in one or both ears related to an abnormal functionality of the cochlear nerve. Evidence: TAS. Frequency: Frequent (HP:0040282). (ORPHA:579)
- Retinopathy (HP:0000488): Any noninflammatory disease of the retina. This nonspecific term is retained here because of its wide use in the literature, but if possible new annotations should indicate the precise type of retinal abnormality. Evidence: TAS. Frequency: Frequent (HP:0040282). (ORPHA:579)
- Glaucoma (HP:0000501): Glaucoma refers loss of retinal ganglion cells in a characteristic pattern of optic neuropathy usually associated with increased intraocular pressure. Evidence: TAS. Frequency: Frequent (HP:0040282). (ORPHA:579)
- Visual impairment (HP:0000505): Visual impairment (or vision impairment) is vision loss (of a person) to such a degree as to qualify as an additional support need through a significant limitation of visual capability resulting from either disease, trauma, or congenital or degenerative conditions that cannot be corrected by conventional means, such as refractive correction, medication, or surgery. Evidence: TAS. Frequency: Occasional (HP:0040283). (ORPHA:579)
- Optic atrophy (HP:0000648): Atrophy of the optic nerve. Optic atrophy results from the death of the retinal ganglion cell axons that comprise the optic nerve and manifesting as a pale optic nerve on fundoscopy. Evidence: TAS. Frequency: Occasional (HP:0040283). (ORPHA:579)
- Widely spaced teeth (HP:0000687): Increased spaces (diastemata) between most of the teeth in the same dental arch. Evidence: TAS. Frequency: Frequent (HP:0040282). (ORPHA:579)
- Microdontia (HP:0000691): Decreased size of the teeth, which can be defined as a mesiodistal tooth diameter (width) more than 2 SD below mean. Alternatively, an apparently decreased maximum width of tooth. Evidence: TAS. Frequency: Frequent (HP:0040282). (ORPHA:579)
- Abnormal metaphysis morphology (HP:0000944): An abnormality of one or more metaphysis, i.e., of the somewhat wider portion of a long bone that is adjacent to the epiphyseal growth plate and grows during childhood. Evidence: TAS. Frequency: Very frequent (HP:0040281). (ORPHA:579)
- Split hand (HP:0001171): A condition in which middle parts of the hand (fingers and metacarpals) are missing giving a cleft appearance. The severity is very variable ranging from slightly hypoplastic middle fingers over absent middle fingers as far as oligo- or monodactyl hands. Evidence: TAS. Frequency: Very frequent (HP:0040281). (ORPHA:579)
- Intellectual disability (HP:0001249): The term intellectual disability or intellectual developmental disorder is used to describe significantly sub-average intellectual and adaptive functioning based on clinical assessment and as measured by individually administered, appropriately normed, standardized and validated tests of intellectual functioning and adaptive behavior, with onset during the developmental period from infancy through adolescence. Evidence: TAS. Frequency: Frequent (HP:0040282). (ORPHA:579)
- Joint dislocation (HP:0001373): Displacement or malalignment of joints. Evidence: TAS. Frequency: Occasional (HP:0040283). (ORPHA:579)
- Joint stiffness (HP:0001387): Joint stiffness is a perceived sensation of tightness in a joint or joints when attempting to move them after a period of inactivity. Joint stiffness typically subsides over time. Evidence: TAS. Frequency: Very frequent (HP:0040281). (ORPHA:579)
- Abnormality of the voice (HP:0001608). Evidence: TAS. Frequency: Very frequent (HP:0040281). (ORPHA:579)
- Congestive heart failure (HP:0001635): The presence of an abnormality of cardiac function that is responsible for the failure of the heart to pump blood at a rate that is commensurate with the needs of the tissues or a state in which abnormally elevated filling pressures are required for the heart to do so. Heart failure is frequently related to a defect in myocardial contraction. Evidence: TAS. Frequency: Occasional (HP:0040283). (ORPHA:579)
- Hypertrophic cardiomyopathy (HP:0001639): Hypertrophic cardiomyopathy (HCM) is defined by the presence of increased ventricular wall thickness or mass in the absence of loading conditions (hypertension, valve disease) sufficient to cause the observed abnormality. Evidence: TAS. Frequency: Occasional (HP:0040283). (ORPHA:579)
- Abnormal aortic valve morphology (HP:0001646): Any abnormality of the aortic valve. Evidence: TAS. Frequency: Occasional (HP:0040283). (ORPHA:579)
- Abnormal heart valve morphology (HP:0001654): Any structural abnormality of a cardiac valve. Evidence: TAS. Frequency: Occasional (HP:0040283). (ORPHA:579)
- Splenomegaly (HP:0001744): Abnormal increased size of the spleen. Evidence: TAS. Frequency: Very frequent (HP:0040281). (ORPHA:579)
- Malabsorption (HP:0002024): Impaired ability to absorb one or more nutrients from the intestine. Evidence: TAS. Frequency: Frequent (HP:0040282). (ORPHA:579)
- Apnea (HP:0002104): Lack of breathing with no movement of the respiratory muscles and no exchange of air in the lungs. This term refers to a disposition to have recurrent episodes of apnea rather than to a single event. Evidence: TAS. Frequency: Frequent (HP:0040282). (ORPHA:579)
- Recurrent respiratory infections (HP:0002205): An increased susceptibility to respiratory infections as manifested by a history of recurrent respiratory infections. Evidence: TAS. Frequency: Frequent (HP:0040282). (ORPHA:579)
- Generalized hirsutism (HP:0002230): Abnormally increased hair growth over much of the entire body. Evidence: TAS. Frequency: Very frequent (HP:0040281). (ORPHA:579)
- Developmental regression (HP:0002376): Loss of developmental skills, as manifested by loss of developmental milestones. Evidence: TAS. Frequency: Frequent (HP:0040282). (ORPHA:579)
- Scoliosis (HP:0002650): The presence of an abnormal lateral curvature of the spine. Evidence: TAS. Frequency: Very frequent (HP:0040281). (ORPHA:579)
- Arthralgia (HP:0002829): Joint pain. Evidence: TAS. Frequency: Frequent (HP:0040282). (ORPHA:579)
- Abnormal hip bone morphology (HP:0003272): An abnormality of the hip bone. Evidence: TAS. Frequency: Frequent (HP:0040282). (ORPHA:579)
- Abnormal vertebral body morphology (HP:0003312): Abnormal form of vertebral body, which is the central cylindrical portion of the vertebra that together with other structures such as the vertebral arch, pedicles, laminae, spinous process, transverse processes, and articular facets makes up a vertebra. Evidence: TAS. Frequency: Very frequent (HP:0040281). (ORPHA:579)
- Paresthesia (HP:0003401): Abnormal sensations such as tingling, pricking, or numbness of the skin with no apparent physical cause. Evidence: TAS. Frequency: Frequent (HP:0040282). (ORPHA:579)
- Spinal canal stenosis (HP:0003416): An abnormal narrowing of the spinal canal. Evidence: TAS. Frequency: Occasional (HP:0040283). (ORPHA:579)
- Short stature (HP:0004322): A height below that which is expected according to age and gender norms. Although there is no universally accepted definition of short stature, many refer to "short stature" as height more than 2 standard deviations below the mean for age and gender (or below the 3rd percentile for age and gender dependent norms). Evidence: TAS. Frequency: Very frequent (HP:0040281). (ORPHA:579)
- Hemiplegia/hemiparesis (HP:0004374): Loss of strength in the arm, leg, and sometimes face on one side of the body. Hemiplegia refers to a severe or complete loss of strength, whereas hemiparesis refers to a relatively mild loss of strength. Evidence: TAS. Frequency: Occasional (HP:0040283). (ORPHA:579)
- Abnormal nasal morphology (HP:0005105). Evidence: TAS. Frequency: Frequent (HP:0040282). (ORPHA:579)
- Depressed nasal bridge (HP:0005280): Posterior positioning of the nasal root in relation to the overall facial profile for age. Evidence: TAS. Frequency: Frequent (HP:0040282). (ORPHA:579)
- Abnormal epiphysis morphology (HP:0005930): An anomaly of epiphysis, which is the expanded articular end of a long bone that developes from a secondary ossification center, and which during the period of growth is either entirely cartilaginous or is separated from the shaft by a cartilaginous disk. Evidence: TAS. Frequency: Very frequent (HP:0040281). (ORPHA:579)
- Corneal opacity (HP:0007957): A reduction of corneal clarity. Evidence: TAS. Frequency: Very frequent (HP:0040281). (ORPHA:579)
- Mucopolysacchariduria (HP:0008155): Excessive amounts of mucopolysaccharide in the urine. Evidence: TAS. Frequency: Very frequent (HP:0040281). (ORPHA:579)
- Thick nasal alae (HP:0009928): Increase in bulk of the ala nasi. Evidence: TAS. Frequency: Frequent (HP:0040282). (ORPHA:579)
- Avascular necrosis (HP:0010885): A disease where there is cellular death (necrosis) of bone components due to interruption of the blood supply. Evidence: TAS. Frequency: Occasional (HP:0040283). (ORPHA:579)
- Cough (HP:0012735): A sudden, audible expulsion of air from the lungs through a partially closed glottis, preceded by inhalation. Evidence: TAS. Frequency: Frequent (HP:0040282). (ORPHA:579)
- Abnormal tendon morphology (HP:0100261): An abnormality of the structure or form of the tendons, also often called sinews. Evidence: TAS. Frequency: Occasional (HP:0040283). (ORPHA:579)
- Enlarged thorax (HP:0100625). Evidence: TAS. Frequency: Frequent (HP:0040282). (ORPHA:579)
- Abnormality of the tonsils (HP:0100765): An abnormality of the tonsils. Evidence: TAS. Frequency: Frequent (HP:0040282). (ORPHA:579)
- Hernia (HP:0100790). Evidence: TAS. Frequency: Very frequent (HP:0040281). (ORPHA:579)
These phenotypes are associated with the disease Mucopolysaccharidosis type 1 (ORPHA:579).